- Neoplasm (HP:0002664): An organ or organ-system abnormality that consists of uncontrolled autonomous cell-proliferation which can occur in any part of the body as a benign or malignant neoplasm (tumor). Evidence: IEA. (OMIM:102660)
- Autosomal dominant inheritance (HP:0000006): A mode of inheritance that is observed for traits related to a gene encoded on one of the autosomes (i.e., the human chromosomes 1-22) in which a trait manifests in heterozygotes. In the context of medical genetics, an autosomal dominant disorder is caused when a single copy of the mutant allele is present. Males and females are affected equally, and can both transmit the disorder with a risk of 50% for each child of inheriting the mutant allele. Evidence: IEA. (OMIM:102660)
These phenotypes are associated with the disease adamantinoma (OMIM:102660).